Phenotypes associated with the disease Fanconi anemia complementation group R (OMIM:617244):
- Congenital onset (HP:0003577): A phenotypic abnormality that is present at birth. Evidence: PCS. Frequency: 1/1. (PMID:26253028)
- Microcephaly (HP:0000252): Head circumference below 2 standard deviations below the mean for age and gender. Evidence: PCS. Frequency: 2/2. (PMID:26253028;PMID:26681308)
- Nevus (HP:0003764): A nevus is a type of hamartoma that is a circumscribed stable malformation of the skin. Evidence: PCS. Frequency: 1/1. (PMID:26253028)
- Anal atresia (HP:0002023): Congenital absence of the anus, i.e., the opening at the bottom end of the intestinal tract. Evidence: PCS. Frequency: 1/1. (PMID:26681308)
- Scoliosis (HP:0002650): The presence of an abnormal lateral curvature of the spine. Evidence: PCS. Frequency: 1/1. (PMID:26253028)
- Tethered cord (HP:0002144): During normal embryological development, the spinal cord first occupies the entire length of the vertebral column but goes on to assume a position at the level of L1 due to differential growth of the conus medullaris and the vertebral column. The filum terminale is a slender, threadlike structure that remains after the normal regression of the distal embryonic spinal cord and attaches the spinal cord to the coccyx. A tethered cord results if there is a thickened rope-like filum terminale which anchors the cord at the level of L2 or below, potentially causing neurologic signs owing to abnormal tension on the spinal cord. Evidence: PCS. Frequency: 1/1. (PMID:26253028)
- Delayed ability to walk (HP:0031936): A failure to achieve the ability to walk at an appropriate developmental stage. Most children learn to walk in a series of stages, and learn to walk short distances independently between 12 and 15 months. Evidence: PCS. Frequency: 1/1. (PMID:26253028)
- Chromosomal breakage induced by crosslinking agents (HP:0003221): Increased amount of chromosomal breaks in cultured blood lymphocytes or other cells induced by treatment with DNA cross-linking agents such as diepoxybutane and mitomycin C. Evidence: PCS. Frequency: 2/2. (PMID:26253028;PMID:26681308)
- Anemia (HP:0001903): A reduction in erythrocytes volume or hemoglobin concentration. Evidence: PCS. Frequency: 0/1. (PMID:26681308)
- Chiari type I malformation (HP:0007099): Arnold-Chiari type I malformation refers to a relatively mild degree of herniation of the posteroinferior region of the cerebellum (the cerebellar tonsils) into the cervical canal with little or no displacement of the fourth ventricle. It is characterized by one or both pointed (not rounded) cerebellar tonsils that project 5 mm below the foramen magnum, measured by a line drawn from the basion to the opisthion (McRae Line). Evidence: PCS. Frequency: 1/1. (PMID:26253028)
- Hydrocephalus (HP:0000238): Hydrocephalus is an active distension of the ventricular system of the brain resulting from inadequate passage of CSF from its point of production within the cerebral ventricles to its point of absorption into the systemic circulation. Evidence: PCS. Frequency: 1/1. (PMID:26681308)
- Microphthalmia (HP:0000568): A developmental anomaly characterized by abnormal smallness of one or both eyes. Evidence: PCS. Frequency: 1/1. (PMID:26253028)
- Absent thumb (HP:0009777): Absent thumb, i.e., the absence of both phalanges of a thumb and the associated soft tissues. Evidence: PCS. Frequency: 1/1. (PMID:26253028)
- Radial ray deficiency (HP:0006433): Radial dysplasia, also known as radial longitudinal deficiency, includes radial clubhand and is a disfiguring, and potentially disabling, congenital limb anomaly. The entire upper limb may be involved, although the defect is most evident in the forearm and hand. Affected children suffer a variable degree of hypoplasia or absence of the preaxial skeleton and soft tissues, in particular the thumb, radius, and dorsoradial soft tissues. The hand is usually radially deviated and subluxated off the distal aspect of the ulna, the ulna may be shortened and have a bow-shaped deformity, and there is no true wrist (radiocarpal) joint in Bayne2 type-III and IV radial dysplasia. Evidence: PCS. Frequency: 1/1. (PMID:26253028)
- Bone marrow hypocellularity (HP:0005528): A reduced number of hematopoietic cells present in the bone marrow relative to marrow fat. Evidence: PCS. Frequency: 0/1. (PMID:26681308)
- Pelvic kidney (HP:0000125): A developmental defect in which a kidney is located in an abnormal anatomic position within the pelvis. Evidence: PCS. Frequency: 1/1. (PMID:26253028)
- Growth delay (HP:0001510): A deficiency or slowing down of growth pre- and postnatally. Evidence: PCS. Frequency: 1/1. (PMID:26681308)
- Autosomal dominant inheritance (HP:0000006): A mode of inheritance that is observed for traits related to a gene encoded on one of the autosomes (i.e., the human chromosomes 1-22) in which a trait manifests in heterozygotes. In the context of medical genetics, an autosomal dominant disorder is caused when a single copy of the mutant allele is present. Males and females are affected equally, and can both transmit the disorder with a risk of 50% for each child of inheriting the mutant allele. Evidence: PCS. (PMID:26681308)
- Intellectual disability (HP:0001249): The term intellectual disability or intellectual developmental disorder is used to describe significantly sub-average intellectual and adaptive functioning based on clinical assessment and as measured by individually administered, appropriately normed, standardized and validated tests of intellectual functioning and adaptive behavior, with onset during the developmental period from infancy through adolescence. Evidence: PCS. Frequency: 1/1. (PMID:26681308)
- Agenesis of permanent teeth (HP:0006349): A congenital defect characterized by the absence of one or more permanent teeth, including oligodontia, hypodontia, and adontia of the of permanent teeth. Evidence: PCS. Frequency: 1/1. (PMID:26253028)